Phenotypes associated with the disease CGF1 (OMIM:300082):
- Abnormality of the nervous system (HP:0000707): An abnormality of the nervous system. Evidence: IEA. (OMIM:300082)